- Abnormality of the kidney (HP:0000077): An abnormality of the kidney. Evidence: TAS. Frequency: Very frequent (HP:0040281). (ORPHA:2838)
- Abnormality of the urinary system (HP:0000079): An abnormality of the urinary system. Evidence: TAS. Frequency: Very frequent (HP:0040281). (ORPHA:2838)
- Sensorineural hearing impairment (HP:0000407): A type of hearing impairment in one or both ears related to an abnormal functionality of the cochlear nerve. Evidence: TAS. Frequency: Very frequent (HP:0040281). (ORPHA:2838)
- Hydroureter (HP:0000072): The distention of the ureter with urine. Evidence: TAS. Frequency: Occasional (HP:0040283). (ORPHA:2838)
- Hydronephrosis (HP:0000126): Severe distention of the kidney with dilation of the renal pelvis and calices. Evidence: TAS. Frequency: Occasional (HP:0040283). (ORPHA:2838)
- Abnormality of the upper urinary tract (HP:0010935): An abnormality of the upper urinary tract. Evidence: TAS. Frequency: Occasional (HP:0040283). (ORPHA:2838)
These phenotypes are associated with the disease Renal caliceal diverticuli-deafness syndrome (ORPHA:2838).